- Torticollis (HP:0000473, a Human Phenotype Ontology term): Involuntary contractions of the neck musculature resulting in an abnormal posture of or abnormal movements of the head. Evidence: TAS. Frequency: Very frequent (HP:0040281, a Human Phenotype Ontology term). (ORPHA:71518)
- Abnormal head movements (HP:0002457, a Human Phenotype Ontology term). Evidence: TAS. Frequency: Frequent (HP:0040282, a Human Phenotype Ontology term). (ORPHA:71518)
- Irritability (HP:0000737, a Human Phenotype Ontology term): An emotional state characterized by negative feelings of heightened frustration, annoyance, or feeling upset, often triggered by internal factors (e.g., fatigue, hunger, unfulfilled desires) or external factors (e.g., social or environmental challenges). Irritability may be unpredictable, and is accompanied by a lowered threshold for emotional reactivity and observable features (speech, facial expressions, or psychomotor activity). Evidence: TAS. Frequency: Frequent (HP:0040282, a Human Phenotype Ontology term). (ORPHA:71518)
- Apathy (HP:0000741, a Human Phenotype Ontology term): Apathy is a quantitative reduction of interest, motivation and the initiation and persistence of goal-directed behavior, where often the accompanying emotions, thoughts, and social interactions are also diminished. The individual is typically non-reactive to provocations, positive or negative, and appears to not care. Distinguished from lethargy which involves lack of physical or mental energy. Evidence: TAS. Frequency: Frequent (HP:0040282, a Human Phenotype Ontology term). (ORPHA:71518)
- Pallor (HP:0000980, a Human Phenotype Ontology term): Abnormally pale skin. Evidence: TAS. Frequency: Frequent (HP:0040282, a Human Phenotype Ontology term). (ORPHA:71518)
- Ataxia (HP:0001251, a Human Phenotype Ontology term): Ataxia refers to impaired coordination of voluntary muscle movement. Cerebellar ataxia refers to ataxia due to dysfunction of the cerebellum. This causes a variety of elementary neurological deficits including asynergy (lack of coordination between muscles, limbs and joints), dysmetria (lack of ability to judge distances that can lead to under- or overshoot in grasping movements), and dysdiadochokinesia (inability to perform rapid movements requiring antagonizing muscle groups to be switched on and off repeatedly). Evidence: TAS. Frequency: Frequent (HP:0040282, a Human Phenotype Ontology term). (ORPHA:71518)
- Vomiting (HP:0002013, a Human Phenotype Ontology term): Forceful ejection of the contents of the stomach through the mouth by means of a series of involuntary spasmic contractions. Evidence: TAS. Frequency: Frequent (HP:0040282, a Human Phenotype Ontology term). (ORPHA:71518)
- Migraine (HP:0002076, a Human Phenotype Ontology term): Migraine is a chronic neurological disorder characterized by episodic attacks of headache and associated symptoms. Evidence: TAS. Frequency: Frequent (HP:0040282, a Human Phenotype Ontology term). (ORPHA:71518)
- Vertigo (HP:0002321, a Human Phenotype Ontology term): An abnormal sensation of spinning while the body is actually stationary. Evidence: TAS. Frequency: Frequent (HP:0040282, a Human Phenotype Ontology term). (ORPHA:71518)
- Drowsiness (HP:0002329, a Human Phenotype Ontology term): Abnormal feeling of sleepiness or difficulty staying awake. Evidence: TAS. Frequency: Frequent (HP:0040282, a Human Phenotype Ontology term). (ORPHA:71518)
These phenotypes are associated with the disease Benign paroxysmal torticollis of infancy (ORPHA:71518, an Orphanet rare-disease identifier).